- Atypical behavior (HP:0000708): Atypical behavior is an abnormality in a person's actions that can be controlled or modulated by the will of the individual. While abnormal behaviors can be difficult to control, they are distinct from other abnormal actions that cannot be affected by the individual's will. Evidence: TAS. Frequency: Very frequent (HP:0040281). (ORPHA:100006)
- Dementia (HP:0000726): A loss of global cognitive ability of sufficient amount to interfere with normal social or occupational function. Dementia represents a loss of previously present cognitive abilities, generally in adults, and can affect memory, thinking, language, judgment, and behavior. Evidence: TAS. Frequency: Very frequent (HP:0040281). (ORPHA:100006)
- Seizure (HP:0001250): A seizure is an intermittent abnormality of nervous system physiology characterized by a transient occurrence of signs and/or symptoms due to abnormal excessive or synchronous neuronal activity in the brain. Evidence: TAS. Frequency: Frequent (HP:0040282). (ORPHA:100006)
- Mental deterioration (HP:0001268): Loss of previously present mental abilities, generally in adults. Evidence: TAS. Frequency: Very frequent (HP:0040281). (ORPHA:100006)
- Stroke (HP:0001297): Sudden impairment of blood flow to a part of the brain due to occlusion or rupture of an artery to the brain. Evidence: TAS. Frequency: Very frequent (HP:0040281). (ORPHA:100006)
- Cerebral hemorrhage (HP:0001342): Hemorrhage into the parenchyma of the brain. Evidence: TAS. Frequency: Very frequent (HP:0040281). (ORPHA:100006)
- Headache (HP:0002315): Cephalgia, or pain sensed in various parts of the head, not confined to the area of distribution of any nerve. Evidence: TAS. Frequency: Very frequent (HP:0040281). (ORPHA:100006)
- Cerebral calcification (HP:0002514): The presence of calcium deposition within the cerebrum. Evidence: TAS. Frequency: Frequent (HP:0040282). (ORPHA:100006)
- Cerebral amyloid angiopathy (HP:0011970): Amyloid deposition in the walls of leptomeningeal and cortical arteries, arterioles, and less often capillaries and veins of the central nervous system. Evidence: TAS. Frequency: Frequent (HP:0040282). (ORPHA:100006)
- Death in early adulthood (HP:0100613): Death between the age of 16 and 40 years. Evidence: TAS. Frequency: Occasional (HP:0040283). (ORPHA:100006)
These phenotypes are associated with the disease ABeta amyloidosis, Dutch type (ORPHA:100006).